Phenotypes associated with the disease Spondylocamptodactyly syndrome (ORPHA:3180):
- Platyspondyly (HP:0000926): A flattened vertebral body shape with reduced distance between the vertebral endplates. Evidence: TAS. Frequency: Very frequent (HP:0040281). (ORPHA:3180)
- Scoliosis (HP:0002650): The presence of an abnormal lateral curvature of the spine. Evidence: TAS. Frequency: Very frequent (HP:0040281). (ORPHA:3180)
- Camptodactyly of finger (HP:0100490): The distal interphalangeal joint and/or the proximal interphalangeal joint of the fingers cannot be extended to 180 degrees by either active or passive extension. Evidence: TAS. Frequency: Very frequent (HP:0040281). (ORPHA:3180)